Phenotypes associated with the disease Facial dysmorphism-developmental delay-behavioral abnormalities syndrome due to WAC point mutation (ORPHA:466950):
- Atypical behavior (HP:0000708): Atypical behavior is an abnormality in a person's actions that can be controlled or modulated by the will of the individual. While abnormal behaviors can be difficult to control, they are distinct from other abnormal actions that cannot be affected by the individual's will. Evidence: TAS. Frequency: Very frequent (HP:0040281). (ORPHA:466950)
- Intellectual disability (HP:0001249): The term intellectual disability or intellectual developmental disorder is used to describe significantly sub-average intellectual and adaptive functioning based on clinical assessment and as measured by individually administered, appropriately normed, standardized and validated tests of intellectual functioning and adaptive behavior, with onset during the developmental period from infancy through adolescence. Evidence: TAS. Frequency: Very frequent (HP:0040281). (ORPHA:466950)
- Mild intellectual disability (HP:0001256): Mild intellectual disability (ID) is defined as a type of ID characterized by mildly sub-average adaptive functioning and intellectual functioning, with an intelligence quotient (IQ) the range of 50-69. Evidence: TAS. Frequency: Very frequent (HP:0040281). (ORPHA:466950)
- Global developmental delay (HP:0001263): A delay in the achievement of motor or mental milestones in the domains of development of a child, including motor skills, speech and language, cognitive skills, and social and emotional skills. This term should only be used to describe children younger than five years of age. Evidence: TAS. Frequency: Very frequent (HP:0040281). (ORPHA:466950)
- Motor delay (HP:0001270): A type of Developmental delay characterized by a delay in acquiring motor skills. Evidence: TAS. Frequency: Very frequent (HP:0040281). (ORPHA:466950)
- Abnormal facial shape (HP:0001999): An abnormal morphology (form) of the face or its components. Evidence: TAS. Frequency: Very frequent (HP:0040281). (ORPHA:466950)
- Square face (HP:0000321): Facial contours, as viewed from the front, show a broad upper face/cranium and lower face/mandible, creating a square appearance. Evidence: TAS. Frequency: Frequent (HP:0040282). (ORPHA:466950)
- Strabismus (HP:0000486): A misalignment of the eyes so that the visual axes deviate from bifoveal fixation. The classification of strabismus may be based on a number of features including the relative position of the eyes, whether the deviation is latent or manifest, intermittent or constant, concomitant or otherwise and according to the age of onset and the relevance of any associated refractive error. Evidence: TAS. Frequency: Frequent (HP:0040282). (ORPHA:466950)
- Abnormality of vision (HP:0000504): Abnormality of eyesight (visual perception). Evidence: TAS. Frequency: Frequent (HP:0040282). (ORPHA:466950)
- Anxiety (HP:0000739): Intense feelings of nervousness, tension, or panic often arise in response to interpersonal stresses. There is worry about the negative effects of past unpleasant experiences and future negative possibilities. Individuals may feel fearful, apprehensive, or threatened by uncertainty, and they may also have fears of falling apart or losing control. Evidence: TAS. Frequency: Frequent (HP:0040282). (ORPHA:466950)
- Delayed speech and language development (HP:0000750): A degree of language development that is significantly below the norm for a child of a specified age. Evidence: TAS. Frequency: Frequent (HP:0040282). (ORPHA:466950)
- Neonatal hypotonia (HP:0001319): Muscular hypotonia (abnormally low muscle tone) manifesting in the neonatal period. Evidence: TAS. Frequency: Frequent (HP:0040282). (ORPHA:466950)
- Constipation (HP:0002019): Infrequent or difficult evacuation of feces. Evidence: TAS. Frequency: Frequent (HP:0040282). (ORPHA:466950)
- Abnormality of the respiratory system (HP:0002086): An abnormality of the respiratory system, which include the airways, lungs, and the respiratory muscles. Evidence: TAS. Frequency: Frequent (HP:0040282). (ORPHA:466950)
- Sleep disturbance (HP:0002360): An abnormal pattern in the quality, quantity, or characteristics of sleep. Evidence: TAS. Frequency: Frequent (HP:0040282). (ORPHA:466950)
- Attention deficit hyperactivity disorder (HP:0007018): Attention deficit hyperactivity disorder (ADHD) manifests at age 2-3 years or by first grade at the latest. The main symptoms are distractibility, impulsivity, hyperactivity, and often trouble organizing tasks and projects, difficulty going to sleep, and social problems from being aggressive, loud, or impatient. Evidence: TAS. Frequency: Frequent (HP:0040282). (ORPHA:466950)
- Pelvic kidney (HP:0000125): A developmental defect in which a kidney is located in an abnormal anatomic position within the pelvis. Evidence: TAS. Frequency: Occasional (HP:0040283). (ORPHA:466950)
- Wide mouth (HP:0000154): Distance between the oral commissures more than 2 SD above the mean. Alternatively, an apparently increased width of the oral aperture (subjective). Evidence: TAS. Frequency: Occasional (HP:0040283). (ORPHA:466950)
- Thin upper lip vermilion (HP:0000219): Height of the vermilion of the upper lip in the midline more than 2 SD below the mean. Alternatively, an apparently reduced height of the vermilion of the upper lip in the frontal view (subjective). Evidence: TAS. Frequency: Occasional (HP:0040283). (ORPHA:466950)
- Epicanthus (HP:0000286): A fold of skin starting above the medial aspect of the upper eyelid and arching downward to cover, pass in front of and lateral to the medial canthus. Evidence: TAS. Frequency: Occasional (HP:0040283). (ORPHA:466950)
- Hypertelorism (HP:0000316): Interpupillary distance more than 2 SD above the mean (alternatively, the appearance of an increased interpupillary distance or widely spaced eyes). Evidence: TAS. Frequency: Occasional (HP:0040283). (ORPHA:466950)
- Broad forehead (HP:0000337): Width of the forehead or distance between the frontotemporales is more than two standard deviations above the mean (objective); or apparently increased distance between the two sides of the forehead. Evidence: TAS. Frequency: Occasional (HP:0040283). (ORPHA:466950)
- Posteriorly rotated ears (HP:0000358): A type of abnormal location of the ears in which the position of the ears is characterized by posterior rotation (the superior part of the ears is rotated towards the back of the head, and the inferior part of the ears towards the front). Evidence: TAS. Frequency: Occasional (HP:0040283). (ORPHA:466950)
- Hearing impairment (HP:0000365): A decreased magnitude of the sensory perception of sound. Evidence: TAS. Frequency: Occasional (HP:0040283). (ORPHA:466950)
- Prominent antihelix (HP:0000395): The presence of an abnormally prominent antihelix. Evidence: TAS. Frequency: Occasional (HP:0040283). (ORPHA:466950)
- Bulbous nose (HP:0000414): Increased volume and globular shape of the anteroinferior aspect of the nose. Evidence: TAS. Frequency: Occasional (HP:0040283). (ORPHA:466950)
- Wide nasal bridge (HP:0000431): Increased breadth of the nasal bridge (and with it, the nasal root). Evidence: TAS. Frequency: Occasional (HP:0040283). (ORPHA:466950)
- Broad nasal tip (HP:0000455): Increase in width of the nasal tip. Evidence: TAS. Frequency: Occasional (HP:0040283). (ORPHA:466950)
- Deeply set eye (HP:0000490): An eye that is more deeply recessed into the plane of the face than is typical. Evidence: TAS. Frequency: Occasional (HP:0040283). (ORPHA:466950)
- Abnormality of refraction (HP:0000539): An abnormality in the process of focusing of light by the eye in order to produce a sharp image on the retina. Evidence: TAS. Frequency: Occasional (HP:0040283). (ORPHA:466950)
- Visual loss (HP:0000572): Loss of visual acuity (implying that vision was better at a certain time point in life). Otherwise the term reduced visual acuity should be used (or a subclass of that). Evidence: TAS. Frequency: Occasional (HP:0040283). (ORPHA:466950)
- Thick eyebrow (HP:0000574): Increased density/number and/or increased diameter of eyebrow hairs. Evidence: TAS. Frequency: Occasional (HP:0040283). (ORPHA:466950)
- Long palpebral fissure (HP:0000637): Distance between medial and lateral canthi is more than two standard deviations above the mean for age (objective); or, apparently increased length of the palpebral fissures. Evidence: TAS. Frequency: Occasional (HP:0040283). (ORPHA:466950)
- Synophrys (HP:0000664): Meeting of the medial eyebrows in the midline. Evidence: TAS. Frequency: Occasional (HP:0040283). (ORPHA:466950)
- Aggressive behavior (HP:0000718): Behavior or an act aimed at harming a person, animal, or physical property (e.g., acts of physical violence; shouting, swearing, and using harsh language; slashing someone's tires). Evidence: TAS. Frequency: Occasional (HP:0040283). (ORPHA:466950)
- Autistic behavior (HP:0000729): Persistent deficits in social interaction and communication and interaction as well as a markedly restricted repertoire of activity and interest as well as repetitive patterns of behavior. Evidence: TAS. Frequency: Occasional (HP:0040283). (ORPHA:466950)
- Single transverse palmar crease (HP:0000954): The distal and proximal transverse palmar creases are merged into a single transverse palmar crease. Evidence: TAS. Frequency: Occasional (HP:0040283). (ORPHA:466950)
- Hirsutism (HP:0001007): Abnormally increased hair growth referring to a male pattern of body hair (androgenic hair). Evidence: TAS. Frequency: Occasional (HP:0040283). (ORPHA:466950)
- Brachydactyly (HP:0001156): Digits that appear disproportionately short compared to the hand/foot. The word brachydactyly is used here to describe a series distinct patterns of shortened digits (brachydactyly types A-E). This is the sense used here. Evidence: TAS. Frequency: Occasional (HP:0040283). (ORPHA:466950)
- Prominent fingertip pads (HP:0001212): A soft tissue prominence of the ventral aspects of the fingertips. The term "persistent fetal fingertip pads" is often used as a synonym, but should better not be used because it implies knowledge of history of the patient which often does not exist. Evidence: TAS. Frequency: Occasional (HP:0040283). (ORPHA:466950)
- Dysarthria (HP:0001260): Dysarthric speech is a general description referring to a neurological speech disorder characterized by poor articulation. Depending on the involved neurological structures, dysarthria may be further classified as spastic, flaccid, ataxic, hyperkinetic and hypokinetic, or mixed. Evidence: TAS. Frequency: Occasional (HP:0040283). (ORPHA:466950)
- Absent speech (HP:0001344): Complete lack of development of speech and language abilities. Evidence: TAS. Frequency: Occasional (HP:0040283). (ORPHA:466950)
- Obesity (HP:0001513): Accumulation of substantial excess body fat. Evidence: TAS. Frequency: Occasional (HP:0040283). (ORPHA:466950)
- Pes planus (HP:0001763): A foot where the longitudinal arch of the foot is in contact with the ground or floor when the individual is standing; or, in a patient lying supine, a foot where the arch is in contact with the surface of a flat board pressed against the sole of the foot by the examiner with a pressure similar to that expected from weight bearing; or, the height of the arch is reduced. Evidence: TAS. Frequency: Occasional (HP:0040283). (ORPHA:466950)
- Truncal obesity (HP:0001956): Obesity located preferentially in the trunk of the body as opposed to the extremities. Evidence: TAS. Frequency: Occasional (HP:0040283). (ORPHA:466950)
- Dysphagia (HP:0002015): Difficulty in swallowing. Evidence: TAS. Frequency: Occasional (HP:0040283). (ORPHA:466950)
- Gastroesophageal reflux (HP:0002020): A condition in which the stomach contents leak backwards from the stomach into the esophagus through the lower esophageal sphincter. Evidence: TAS. Frequency: Occasional (HP:0040283). (ORPHA:466950)
- Bilateral tonic-clonic seizure (HP:0002069): A bilateral tonic-clonic seizure is a seizure defined by a tonic (bilateral increased tone, lasting seconds to minutes) and then a clonic (bilateral sustained rhythmic jerking) phase. Evidence: TAS. Frequency: Occasional (HP:0040283). (ORPHA:466950)
- Asthma (HP:0002099): Asthma is characterized by increased responsiveness of the tracheobronchial tree to multiple stimuli, leading to narrowing of the air passages with resultant dyspnea, cough, and wheezing. Evidence: TAS. Frequency: Occasional (HP:0040283). (ORPHA:466950)
- Ventriculomegaly (HP:0002119): An increase in size of the ventricular system of the brain. Evidence: TAS. Frequency: Occasional (HP:0040283). (ORPHA:466950)
- Recurrent respiratory infections (HP:0002205): An increased susceptibility to respiratory infections as manifested by a history of recurrent respiratory infections. Evidence: TAS. Frequency: Occasional (HP:0040283). (ORPHA:466950)
- Abnormal pattern of respiration (HP:0002793): An anomaly of the rhythm or depth of breathing. Evidence: TAS. Frequency: Occasional (HP:0040283). (ORPHA:466950)
- Inverted nipples (HP:0003186): The presence of nipples that instead of pointing outward are retracted inwards. Evidence: TAS. Frequency: Occasional (HP:0040283). (ORPHA:466950)
- Short palm (HP:0004279): Short palm. Evidence: TAS. Frequency: Occasional (HP:0040283). (ORPHA:466950)
- Depressed nasal bridge (HP:0005280): Posterior positioning of the nasal root in relation to the overall facial profile for age. Evidence: TAS. Frequency: Occasional (HP:0040283). (ORPHA:466950)
- Abnormal nostril morphology (HP:0005288): Abnormality of the nostril. Evidence: TAS. Frequency: Occasional (HP:0040283). (ORPHA:466950)
- Pes valgus (HP:0008081): An outward (valgus) deviation of the calcaneus relative to the longitudinal axis of the lower leg at the talocalcaneal (subtalar) joint, such that the heel is everted. Evidence: TAS. Frequency: Occasional (HP:0040283). (ORPHA:466950)
- Branchial anomaly (HP:0009794): Congenital developmental defect arising from the primitive branchial apparatus. Evidence: TAS. Frequency: Occasional (HP:0040283). (ORPHA:466950)
- Typical absence seizure (HP:0011147): A typical absence seizure is a type of generalized non-motor (absence) seizure characterized by its sudden onset, interruption of ongoing activities, a blank stare, possibly a brief upward deviation of the eyes. Usually the patient will be unresponsive when spoken to. Duration is a few seconds to half a minute with very rapid recovery. Although not always available, an EEG would usually show 3 Hz generalized epileptiform discharges during the event. Evidence: TAS. Frequency: Occasional (HP:0040283). (ORPHA:466950)
- Simple febrile seizure (HP:0011171): A short generalized seizure, of a duration of <15 min, not recurring within 24 h, occurring during a febrile episode not caused by an acute disease of the nervous system intracranial infection or severe metabolic disturbance. Evidence: TAS. Frequency: Occasional (HP:0040283). (ORPHA:466950)
- Prominent forehead (HP:0011220): Forward prominence of the entire forehead, due to protrusion of the frontal bone. Evidence: TAS. Frequency: Occasional (HP:0040283). (ORPHA:466950)
- Broad chin (HP:0011822): Increased width of the midpoint of the mandible (mental protuberance) and overlying soft tissue. Evidence: TAS. Frequency: Occasional (HP:0040283). (ORPHA:466950)
- Borderline personality disorder (HP:0012076): A personality disorder characterized by impulsive behavior and unpredictable, capricious mood. Affected individuals show a tendency to have outbursts of emotion and an inability to control these behavioral explosions. They generally experience an intense fear of abandonment or instability and also struggle with feelings of emptiness. Evidence: TAS. Frequency: Occasional (HP:0040283). (ORPHA:466950)
- Widened subarachnoid space (HP:0012704): An increase in size of the anatomic space between the arachnoid membrane and pia mater. Evidence: TAS. Frequency: Occasional (HP:0040283). (ORPHA:466950)
- Nasogastric tube feeding (HP:0040288): The condition of inability to eat normally treated by placement of a thin tube through the nose into the stomach that is then used to carry food. Evidence: TAS. Frequency: Occasional (HP:0040283). (ORPHA:466950)
- Dilatation of renal calices (HP:0100581): An abnormal enlargement of the renal calices, the system of ducts of the kidney that collect urine. Evidence: TAS. Frequency: Occasional (HP:0040283). (ORPHA:466950)
- Arachnoid cyst (HP:0100702): An extra-parenchymal and intra-arachnoidal collection of fluid with a composition similar to that of cerebrospinal fluid. Evidence: TAS. Frequency: Occasional (HP:0040283). (ORPHA:466950)
- Self-injurious behavior (HP:0100716): Self-aggression. Evidence: TAS. Frequency: Occasional (HP:0040283). (ORPHA:466950)